Phenotypes associated with the disease apolipoprotein c-III deficiency (OMIM:614028, an entry in Online Mendelian Inheritance in Man):
- Decreased circulating LDL-C concentration (HP:0003563, a Human Phenotype Ontology term): The concentration of low-density lipoprotein cholesterol in the blood circulation is below the lower limit of normal. Evidence: IEA. (PMID:19074352)
- Elevated circulating HDL-C concentration (HP:0012184, a Human Phenotype Ontology term): The concentration of high-density lipoprotein cholesterol in the blood circulation is above the upper limit of normal. Evidence: IEA. (PMID:19074352)
- Hypotriglyceridemia (HP:0012153, a Human Phenotype Ontology term): An decrease in the level of triglycerides in the blood. Evidence: IEA. (PMID:19074352)